- Blood group antigen abnormality (HP:0010970): An abnormality of an erythrocyte cell surface molecule. Evidence: IEA. (OMIM:111400)
- Autosomal dominant inheritance (HP:0000006): A mode of inheritance that is observed for traits related to a gene encoded on one of the autosomes (i.e., the human chromosomes 1-22) in which a trait manifests in heterozygotes. In the context of medical genetics, an autosomal dominant disorder is caused when a single copy of the mutant allele is present. Males and females are affected equally, and can both transmit the disorder with a risk of 50% for each child of inheriting the mutant allele. Evidence: IEA. (OMIM:111400)
These phenotypes are associated with the disease #111400 BLOOD GROUP, P1PK SYSTEMP(1) PHENOTYPE, INCLUDED;;P(2) PHENOTYPE, INCLUDED;;P1(k) PHENOTYPE, INCLUDED;;P2(k) PHENOTYPE, INCLUDED;;p PHENOTYPE, INCLUDED;;NOR POLYAGGLUTINATION SYNDROME, INCLUDED (OMIM:111400).